Phenotypes associated with the disease Dysmorphism-pectus carinatum-joint laxity syndrome (ORPHA:2104):
- Joint hypermobility (HP:0001382): The capability that a joint (or a group of joints) has to move, passively and/or actively, beyond normal limits along physiological axes. Evidence: TAS. Frequency: Very frequent (HP:0040281). (ORPHA:2104)
- Malar flattening (HP:0000272): Underdevelopment of the malar prominence of the jugal bone (zygomatic bone in mammals), appreciated in profile, frontal view, and/or by palpation. Evidence: TAS. Frequency: Very frequent (HP:0040281). (ORPHA:2104)
- Full cheeks (HP:0000293): Increased prominence or roundness of soft tissues between zygomata and mandible. Evidence: TAS. Frequency: Very frequent (HP:0040281). (ORPHA:2104)
- Convex nasal ridge (HP:0000444): Nasal ridge curving anteriorly to an imaginary line that connects the nasal root and tip. The nose appears often also prominent, and the columella low. Evidence: TAS. Frequency: Very frequent (HP:0040281). (ORPHA:2104)
- Depressed nasal ridge (HP:0000457): Lack of prominence of the nose resulting from a posteriorly-placed nasal ridge. Evidence: TAS. Frequency: Very frequent (HP:0040281). (ORPHA:2104)
- Telecanthus (HP:0000506): Distance between the inner canthi more than two standard deviations above the mean (objective); or, apparently increased distance between the inner canthi. Evidence: TAS. Frequency: Very frequent (HP:0040281). (ORPHA:2104)
- Pectus carinatum (HP:0000768): A deformity of the chest caused by overgrowth of the ribs and characterized by protrusion of the sternum. Evidence: TAS. Frequency: Very frequent (HP:0040281). (ORPHA:2104)
- Deep philtrum (HP:0002002): Accentuated, prominent philtral ridges giving rise to an exaggerated groove in the midline between the nasal base and upper vermillion border. Evidence: TAS. Frequency: Very frequent (HP:0040281). (ORPHA:2104)
- Frontal bossing (HP:0002007): Bilateral bulging of the lateral frontal bone prominences with relative sparing of the midline. Evidence: TAS. Frequency: Very frequent (HP:0040281). (ORPHA:2104)
- Genu valgum (HP:0002857): The legs angle inward, such that the knees are close together and the ankles far apart. Evidence: TAS. Frequency: Very frequent (HP:0040281). (ORPHA:2104)
- Tented upper lip vermilion (HP:0010804): Triangular appearance of the oral aperture with the apex in the midpoint of the upper vermilion and the lower vermilion forming the base. Evidence: TAS. Frequency: Very frequent (HP:0040281). (ORPHA:2104)